Phenotypes associated with the disease neuronal ceroid lipofuscinosis 7 (OMIM:610951):
- Visual loss (HP:0000572): Loss of visual acuity (implying that vision was better at a certain time point in life). Otherwise the term reduced visual acuity should be used (or a subclass of that). Evidence: IEA. (OMIM:610951)
- Cerebral atrophy (HP:0002059): Atrophy (wasting, decrease in size of cells or tissue) affecting the cerebrum. Evidence: IEA. (OMIM:610951)
- Juvenile onset (HP:0003621): Onset of signs or symptoms of disease between the age of 5 and 15 years. Evidence: IEA. (OMIM:610951)
- Delayed speech and language development (HP:0000750): A degree of language development that is significantly below the norm for a child of a specified age. Evidence: IEA. (OMIM:610951)
- EEG abnormality (HP:0002353): Abnormality observed by electroencephalogram (EEG), which is used to record of the brain's spontaneous electrical activity from multiple electrodes placed on the scalp. Evidence: IEA. (OMIM:610951)
- Generalized myoclonic seizure (HP:0002123): A generalized myoclonic seizure is a type of generalized motor seizure characterized by bilateral, sudden, brief (<100 ms) involuntary single or multiple contraction of muscles or muscle groups of variable topography (axial, proximal limb, distal). Myoclonus is less regularly repetitive and less sustained than is clonus. Evidence: IEA. (OMIM:610951)
- Cerebellar atrophy (HP:0001272): Cerebellar atrophy is defined as a cerebellum with initially normal structures, in a posterior fossa with normal size, which displays enlarged fissures (interfolial spaces) in comparison to the foliae secondary to loss of tissue. Cerebellar atrophy implies irreversible loss of tissue and result from an ongoing progressive disease until a final stage is reached or a single injury, e.g. an intoxication or infectious event. Evidence: IEA. (OMIM:610951)
- Sleep disturbance (HP:0002360): An abnormal pattern in the quality, quantity, or characteristics of sleep. Evidence: TAS. (OMIM:610951)
- Global developmental delay (HP:0001263): A delay in the achievement of motor or mental milestones in the domains of development of a child, including motor skills, speech and language, cognitive skills, and social and emotional skills. This term should only be used to describe children younger than five years of age. Evidence: TAS. (OMIM:610951)
- Pigmentary retinopathy (HP:0000580): An abnormality of the retina characterized by pigment deposition. It is typically associated with migration and proliferation of macrophages or retinal pigment epithelial cells into the retina; melanin from these cells causes the pigmentary changes. Pigmentary retinopathy is a common final pathway of many retinal conditions and is often associated with visual loss. Evidence: PCS. (PMID:19277732)
- Ataxia (HP:0001251): Ataxia refers to impaired coordination of voluntary muscle movement. Cerebellar ataxia refers to ataxia due to dysfunction of the cerebellum. This causes a variety of elementary neurological deficits including asynergy (lack of coordination between muscles, limbs and joints), dysmetria (lack of ability to judge distances that can lead to under- or overshoot in grasping movements), and dysdiadochokinesia (inability to perform rapid movements requiring antagonizing muscle groups to be switched on and off repeatedly). Evidence: IEA. (OMIM:610951)
- Neurodegeneration (HP:0002180): Progressive loss of neural cells and tissue. Evidence: IEA. (OMIM:610951)
- Blindness (HP:0000618): Blindness is the condition of lacking visual perception defined as a profound reduction in visual perception. On the 6m visual acuity scale, blindness is defined as less than 3/60. On the 20ft visual acuity scale, blindness is defined as less than 20/400. On the decimal visual acuity scale, blindness is defined as less than 0.05. Blindness is typically characterized by a visual field of no greater than 10 degrees in radius around central fixation. Evidence: IEA. (OMIM:610951)
- Autosomal recessive inheritance (HP:0000007): A mode of inheritance that is observed for traits related to a gene encoded on one of the autosomes (i.e., the human chromosomes 1-22) in which a trait manifests in individuals with two pathogenic alleles, either homozygotes (two copies of the same mutant allele) or compound heterozygotes (whereby each copy of a gene has a distinct mutant allele). Evidence: IEA. (OMIM:610951)
- Optic atrophy (HP:0000648): Atrophy of the optic nerve. Optic atrophy results from the death of the retinal ganglion cell axons that comprise the optic nerve and manifesting as a pale optic nerve on fundoscopy. Evidence: IEA. (OMIM:610951)
- Retinopathy (HP:0000488): Any noninflammatory disease of the retina. This nonspecific term is retained here because of its wide use in the literature, but if possible new annotations should indicate the precise type of retinal abnormality. Evidence: TAS. (OMIM:610951)
- Mental deterioration (HP:0001268): Loss of previously present mental abilities, generally in adults. Evidence: IEA. (OMIM:610951)
- Rapidly progressive (HP:0003678): Applies to a disease manifestation that quickly increases in scope or severity over the course of time. Evidence: TAS. (OMIM:610951)